- Macular degeneration (HP:0000608): A nonspecific term denoting degeneration of the retinal pigment epithelium and/or retinal photoreceptor cells of the macula lutea. Evidence: TAS. (OMIM:613757)
This phenotype is associated with the disease age related macular degeneration 6 (OMIM:613757).